- Nausea and vomiting (HP:0002017): Nausea is a commonly encountered symptom that has been defined as an unpleasant painless subjective feeling that one will imminently vomit. Vomiting has been defined as the forceful expulsion of the contents of the stomach, duodenum, or jejunum through the oral cavity. While nausea and vomiting are often thought to exist on a temporal continuum, this is not always the case. There are situations when severe nausea may be present without emesis and less frequently, when emesis may be present without preceding nausea. Evidence: TAS. Frequency: Very frequent (HP:0040281). (ORPHA:168829)
- Constipation (HP:0002019): Infrequent or difficult evacuation of feces. Evidence: TAS. Frequency: Very frequent (HP:0040281). (ORPHA:168829)
- Abdominal pain (HP:0002027): An unpleasant sensation characterized by physical discomfort (such as pricking, throbbing, or aching) and perceived to originate in the abdomen. Evidence: TAS. Frequency: Very frequent (HP:0040281). (ORPHA:168829)
- Peritonitis (HP:0002586): Inflammation of the peritoneum. Evidence: TAS. Frequency: Very frequent (HP:0040281). (ORPHA:168829)
- Neoplasm (HP:0002664): An organ or organ-system abnormality that consists of uncontrolled autonomous cell-proliferation which can occur in any part of the body as a benign or malignant neoplasm (tumor). Evidence: TAS. Frequency: Very frequent (HP:0040281). (ORPHA:168829)
- Abdominal distention (HP:0003270): Distention of the abdomen. Evidence: TAS. Frequency: Very frequent (HP:0040281). (ORPHA:168829)
These phenotypes are associated with the disease Primary peritoneal carcinoma (ORPHA:168829).